- Visual impairment (HP:0000505): Visual impairment (or vision impairment) is vision loss (of a person) to such a degree as to qualify as an additional support need through a significant limitation of visual capability resulting from either disease, trauma, or congenital or degenerative conditions that cannot be corrected by conventional means, such as refractive correction, medication, or surgery. Evidence: TAS. Frequency: Very frequent (HP:0040281). (ORPHA:75373)
- Myopia (HP:0000545): An abnormality of refraction characterized by the ability to see objects nearby clearly, while objects in the distance appear blurry. Evidence: TAS. Frequency: Very frequent (HP:0040281). (ORPHA:75373)
- Esotropia (HP:0000565): A form of strabismus with one or both eyes turned inward ('crossed') to a relatively severe degree, usually defined as 10 diopters or more. Evidence: TAS. Frequency: Very frequent (HP:0040281). (ORPHA:75373)
- Pigmentary retinopathy (HP:0000580): An abnormality of the retina characterized by pigment deposition. It is typically associated with migration and proliferation of macrophages or retinal pigment epithelial cells into the retina; melanin from these cells causes the pigmentary changes. Pigmentary retinopathy is a common final pathway of many retinal conditions and is often associated with visual loss. Evidence: TAS. Frequency: Occasional (HP:0040283). (ORPHA:75373)
- Nystagmus (HP:0000639): Rhythmic, involuntary oscillations of one or both eyes related to abnormality in fixation, conjugate gaze, or vestibular mechanisms. Evidence: TAS. Frequency: Very frequent (HP:0040281). (ORPHA:75373)
- Chorioretinal dystrophy (HP:0001135). Evidence: TAS. Frequency: Very frequent (HP:0040281). (ORPHA:75373)
- Macular atrophy (HP:0007401): A nonspecific term denoting wasting, especially as a result of degeneration, of the retinal pigment epithelium (RPE) and neurosensory retinal cells in the macula. Evidence: TAS. Frequency: Very frequent (HP:0040281). (ORPHA:75373)
These phenotypes are associated with the disease Progressive bifocal chorioretinal atrophy (ORPHA:75373).